- Dysphagia (HP:0002015): Difficulty in swallowing. Evidence: PCS. Frequency: 6/12. (PMID:28469040)
- Middle age onset (HP:0003596): A type of adult onset with onset of symptoms at the age of 40 to 60 years. Evidence: PCS. Frequency: 3/12. (PMID:28469040)
- Degeneration of anterior horn cells (HP:0002398). Evidence: PCS. (PMID:28469040)
- Dementia (HP:0000726): A loss of global cognitive ability of sufficient amount to interfere with normal social or occupational function. Dementia represents a loss of previously present cognitive abilities, generally in adults, and can affect memory, thinking, language, judgment, and behavior. Evidence: PCS. Frequency: 0/12. (PMID:28469040)
- Late onset (HP:0003584): A type of adult onset with onset of symptoms after the age of 60 years. Evidence: PCS. Frequency: 9/12. (PMID:28469040)
- Amyotrophic lateral sclerosis (HP:0007354). Evidence: PCS. Frequency: 12/12. (PMID:28469040)
- Autosomal dominant inheritance (HP:0000006): A mode of inheritance that is observed for traits related to a gene encoded on one of the autosomes (i.e., the human chromosomes 1-22) in which a trait manifests in heterozygotes. In the context of medical genetics, an autosomal dominant disorder is caused when a single copy of the mutant allele is present. Males and females are affected equally, and can both transmit the disorder with a risk of 50% for each child of inheriting the mutant allele. Evidence: PCS. (PMID:28469040)
These phenotypes are associated with the disease amyotrophic lateral sclerosis type 23 (OMIM:617839).